Phenotypes associated with the disease autosomal recessive limb-girdle muscular dystrophy type 2T (OMIM:615352):
- Elevated circulating creatine kinase activity (HP:0003236): The activity of creatine kinase in the blood circulation is above the upper limit of normal. Evidence: PCS. Frequency: 3/3. (PMID:23768512)
- Microcephaly (HP:0000252): Head circumference below 2 standard deviations below the mean for age and gender. Evidence: PCS. Frequency: 2/3. (PMID:23768512)
- Congenital onset (HP:0003577): A phenotypic abnormality that is present at birth. Evidence: PCS. Frequency: 1/3. (PMID:23768512)
- Mild intellectual disability (HP:0001256): Mild intellectual disability (ID) is defined as a type of ID characterized by mildly sub-average adaptive functioning and intellectual functioning, with an intelligence quotient (IQ) the range of 50-69. Evidence: PCS. Frequency: 2/3. (PMID:23768512)
- Seizure (HP:0001250): A seizure is an intermittent abnormality of nervous system physiology characterized by a transient occurrence of signs and/or symptoms due to abnormal excessive or synchronous neuronal activity in the brain. Evidence: PCS. Frequency: 2/3. (PMID:23768512)
- Hypoglycosylation of alpha-dystroglycan (HP:0030046): A reduction in the degree of glycosylation of alpha-dystroglycan in muscle tissue. Evidence: PCS. Frequency: 1/1. (PMID:23768512)
- Hypotonia (HP:0001252): Hypotonia is an abnormally low muscle tone (the amount of tension or resistance to movement in a muscle). Even when relaxed, muscles have a continuous and passive partial contraction which provides some resistance to passive stretching. Hypotonia thus manifests as diminished resistance to passive stretching. Hypotonia is not the same as muscle weakness, although the two conditions can co-exist. Evidence: PCS. Frequency: 1/3. (PMID:23768512)
- Muscular dystrophy (HP:0003560): The term dystrophy means abnormal growth. However, muscular dystrophy is used to describe primary myopathies with a genetic basis and a progressive course characterized by progressive skeletal muscle weakness and wasting, defects in muscle proteins, and histological features of muscle fiber degeneration (necrosis) and regeneration. If possible, it is preferred to use other HPO terms to describe the precise phenotypic abnormalities. Evidence: PCS. (PMID:23768512)
- Motor delay (HP:0001270): A type of Developmental delay characterized by a delay in acquiring motor skills. Evidence: TAS. Frequency: Occasional (HP:0040283). (OMIM:615352)
- Respiratory insufficiency (HP:0002093). Evidence: PCS. Frequency: 1/3. (PMID:23768512)
- Cataract (HP:0000518): A cataract is an opacity or clouding that develops in the crystalline lens of the eye or in its capsule. Evidence: PCS. Frequency: 1/3. (PMID:23768512)
- Nystagmus (HP:0000639): Rhythmic, involuntary oscillations of one or both eyes related to abnormality in fixation, conjugate gaze, or vestibular mechanisms. Evidence: PCS. Frequency: 1/3. (PMID:23768512)
- Childhood onset (HP:0011463): Onset of disease at the age of between 1 and 5 years. Evidence: PCS. Frequency: 2/3. (PMID:23768512)
- Autosomal recessive inheritance (HP:0000007): A mode of inheritance that is observed for traits related to a gene encoded on one of the autosomes (i.e., the human chromosomes 1-22) in which a trait manifests in individuals with two pathogenic alleles, either homozygotes (two copies of the same mutant allele) or compound heterozygotes (whereby each copy of a gene has a distinct mutant allele). Evidence: PCS. (PMID:23768512)
- Cardiomyopathy (HP:0001638): A myocardial disorder in which the heart muscle is structurally and functionally abnormal, in the absence of coronary artery disease, hypertension, valvular disease and congenital heart disease sufficient to cause the observed myocardial abnormality. Evidence: PCS. Frequency: 1/3. (PMID:23768512)
- Proximal muscle weakness (HP:0003701): A lack of strength of the proximal muscles. Evidence: TAS. (OMIM:615352)
- Limb-girdle muscle weakness (HP:0003325): Weakness of the limb-girdle muscles (also known as the pelvic and shoulder girdles), that is, lack of strength of the muscles around the shoulders and the pelvis. Evidence: PCS. Frequency: 3/3. (PMID:23768512)
- Exercise intolerance (HP:0003546): A functional motor deficit where individuals whose responses to the challenges of exercise fail to achieve levels considered normal for their age and gender. Evidence: PCS. Frequency: 1/3. (PMID:23768512)